Phenotypes associated with the disease Laryngeal abductor paralysis-intellectual disability syndrome (ORPHA:2375):
- Vocal cord paralysis (HP:0001605): A loss of the ability to move the vocal folds. Evidence: TAS. Frequency: Obligate (HP:0040280). (ORPHA:2375)
- Bronchiectasis (HP:0002110): Persistent abnormal dilatation of the bronchi owing to localized and irreversible destruction and widening of the large airways. Evidence: TAS. Frequency: Obligate (HP:0040280). (ORPHA:2375)
- Congenital laryngeal stridor (HP:0004886). Evidence: TAS. Frequency: Obligate (HP:0040280). (ORPHA:2375)
- Microcephaly (HP:0000252): Head circumference below 2 standard deviations below the mean for age and gender. Evidence: TAS. Frequency: Frequent (HP:0040282). (ORPHA:2375)
- Motor delay (HP:0001270): A type of Developmental delay characterized by a delay in acquiring motor skills. Evidence: TAS. Frequency: Frequent (HP:0040282). (ORPHA:2375)
- Moderate intellectual disability (HP:0002342): Moderate intellectual disability (ID) is defined as a type of ID characterized by moderately sub-average adaptive functioning and intellectual functioning, with an intelligence quotient (IQ) the range of 35-49. Evidence: TAS. Frequency: Frequent (HP:0040282). (ORPHA:2375)
- Neonatal asphyxia (HP:0012768): Respiratory failure in the newborn. Evidence: TAS. Frequency: Frequent (HP:0040282). (ORPHA:2375)